Phenotypes associated with the disease Nevus of Ito (ORPHA:263432):
- Nevus (HP:0003764): A nevus is a type of hamartoma that is a circumscribed stable malformation of the skin. Evidence: TAS. Frequency: Very frequent (HP:0040281). (ORPHA:263432)
- Cutaneous melanoma (HP:0012056): The presence of a melanoma of the skin. Evidence: TAS. Frequency: Very rare (HP:0040284). (ORPHA:263432)
Not associated with this disease:
- Ocular melanocytosis (HP:0025534): A congenital lesion of the sclera characterized by unilateral patchy but extensive slate-gray or bluish discoloration of the sclera . The conjunctiva are spared. Evidence: TAS. (ORPHA:263432)